- Anti-dsDNA antibody positivity (HP:0020151): The presence of autoantibodies (immunoglobulins) in the serum that react against double-stranded DNA. Evidence: TAS. Frequency: Frequent (HP:0040282). (ORPHA:90002)
- Anti-ribosome Po antibody positivity (HP:0034076): The presence of autoantibodies (immunoglobulins) in the blood circulation that react against ribosome Po. Evidence: TAS. Frequency: Frequent (HP:0040282). (ORPHA:90002)
- Anti-Ro52/TRIM21 antibody positivity (HP:0034093): The presence of autoantibodies (immunoglobulins) in the blood circulation that react against Ro52/TRIM21. Evidence: TAS. Frequency: Frequent (HP:0040282). (ORPHA:90002)
These phenotypes are associated with the disease Undifferentiated connective tissue syndrome (ORPHA:90002).